- Abnormal skull morphology (HP:0000929): An abnormality of the skull, the bony framework of the head which is comprised of the neurocranium (with eight cranial bones) and the viscerocranium (facial skeleton) that comprises fourteen facial bones with the mandible as its largest bone. Evidence: TAS. Frequency: Very frequent (HP:0040281). (ORPHA:945)
- Aplasia/Hypoplasia of the cerebellum (HP:0007360). Evidence: TAS. Frequency: Very frequent (HP:0040281). (ORPHA:945)
- Postaxial hand polydactyly (HP:0001162): Supernumerary digits located at the ulnar side of the hand (that is, on the side with the fifth finger). Evidence: TAS. Frequency: Frequent (HP:0040282). (ORPHA:945)
- Calvarial skull defect (HP:0001362): A localized defect in the bone of the skull resulting from abnormal embryological development. The defect is covered by normal skin. In some cases, skull x-rays have shown underlying lytic bone lesions which have closed before the age of one year. Evidence: TAS. Frequency: Frequent (HP:0040282). (ORPHA:945)
- Abnormality of neuronal migration (HP:0002269): An abnormality resulting from an anomaly of neuronal migration, i.e., of the process by which neurons travel from their origin to their final position in the brain. Evidence: TAS. Frequency: Frequent (HP:0040282). (ORPHA:945)
- Cleft palate (HP:0000175): Cleft palate is a developmental defect of the palate resulting from a failure of fusion of the palatine processes and manifesting as a separation of the roof of the mouth (soft and hard palate). Evidence: TAS. Frequency: Occasional (HP:0040283). (ORPHA:945)
- Hydrocephalus (HP:0000238): Hydrocephalus is an active distension of the ventricular system of the brain resulting from inadequate passage of CSF from its point of production within the cerebral ventricles to its point of absorption into the systemic circulation. Evidence: TAS. Frequency: Occasional (HP:0040283). (ORPHA:945)
- Hypertelorism (HP:0000316): Interpupillary distance more than 2 SD above the mean (alternatively, the appearance of an increased interpupillary distance or widely spaced eyes). Evidence: TAS. Frequency: Occasional (HP:0040283). (ORPHA:945)
- Holoprosencephaly (HP:0001360): Holoprosencephaly is a structural anomaly of the brain in which the developing forebrain fails to divide into two separate hemispheres and ventricles. Evidence: TAS. Frequency: Occasional (HP:0040283). (ORPHA:945)
- Omphalocele (HP:0001539): A midline anterior incomplete closure of the abdominal wall in which there is herniation of the abdominal viscera into the base of the abdominal cord. Evidence: TAS. Frequency: Occasional (HP:0040283). (ORPHA:945)
- Talipes (HP:0001883): A deformity of foot and ankle that has different subtypes that are talipes equinovarus, talipes equinovalgus, talipes calcaneovarus and talipes calcaneovalgus. Evidence: TAS. Frequency: Occasional (HP:0040283). (ORPHA:945)
- Abnormal lung lobation (HP:0002101): A developmental defect in the formation of pulmonary lobes. Evidence: TAS. Frequency: Occasional (HP:0040283). (ORPHA:945)
- Spina bifida (HP:0002414): Incomplete closure of the embryonic neural tube, whereby some vertebral arches remain unfused and open. The mildest form is spina bifida occulta, followed by meningocele and meningomyelocele. Evidence: TAS. Frequency: Occasional (HP:0040283). (ORPHA:945)
- Abnormal cardiovascular system morphology (HP:0030680): Any structural anomaly of the heart and blood vessels. Evidence: TAS. Frequency: Occasional (HP:0040283). (ORPHA:945)
These phenotypes are associated with the disease Acalvaria (ORPHA:945).